Phenotypes associated with the disease Mal de débarquement (ORPHA:210272):
- Gait imbalance (HP:0002141). Evidence: TAS. Frequency: Frequent (HP:0040282). (ORPHA:210272)
- Postural instability (HP:0002172): A tendency to fall or the inability to keep oneself from falling; imbalance. The retropulsion test is widely regarded as the gold standard to evaluate postural instability, Use of the retropulsion test includes a rapid balance perturbation in the backward direction, and the number of balance correcting steps (or total absence thereof) is used to rate the degree of postural instability. Healthy subjects correct such perturbations with either one or two large steps, or without taking any steps, hinging rapidly at the hips while swinging the arms forward as a counterweight. In patients with balance impairment, balance correcting steps are often too small, forcing patients to take more than two steps. Taking three or more steps is generally considered to be abnormal, and taking more than five steps is regarded as being clearly abnormal. Markedly affected patients continue to step backward without ever regaining their balance and must be caught by the examiner (this would be called true retropulsion). Even more severely affected patients fail to correct entirely, and fall backward like a pushed toy soldier, without taking any corrective steps. Evidence: TAS. Frequency: Frequent (HP:0040282). (ORPHA:210272)
- Unsteady gait (HP:0002317). Evidence: TAS. Frequency: Frequent (HP:0040282). (ORPHA:210272)
- Vertigo (HP:0002321): An abnormal sensation of spinning while the body is actually stationary. Evidence: TAS. Frequency: Frequent (HP:0040282). (ORPHA:210272)
- Abnormality of eye movement (HP:0000496): An abnormality in voluntary or involuntary eye movements or their control. Evidence: TAS. Frequency: Occasional (HP:0040283). (ORPHA:210272)
- Blurred vision (HP:0000622): Lack of sharpness of vision resulting in the inability to see fine detail. Evidence: TAS. Frequency: Occasional (HP:0040283). (ORPHA:210272)
- Diplopia (HP:0000651): Diplopia is a condition in which a single object is perceived as two images, it is also known as double vision. Evidence: TAS. Frequency: Occasional (HP:0040283). (ORPHA:210272)
- Anxiety (HP:0000739): Intense feelings of nervousness, tension, or panic often arise in response to interpersonal stresses. There is worry about the negative effects of past unpleasant experiences and future negative possibilities. Individuals may feel fearful, apprehensive, or threatened by uncertainty, and they may also have fears of falling apart or losing control. Evidence: TAS. Frequency: Occasional (HP:0040283). (ORPHA:210272)
- Confusion (HP:0001289): Lack of clarity and coherence of thought, perception, understanding, or action. Evidence: TAS. Frequency: Occasional (HP:0040283). (ORPHA:210272)
- Vomiting (HP:0002013): Forceful ejection of the contents of the stomach through the mouth by means of a series of involuntary spasmic contractions. Evidence: TAS. Frequency: Occasional (HP:0040283). (ORPHA:210272)
- Nausea (HP:0002018): A sensation of unease in the stomach together with an urge to vomit. Evidence: TAS. Frequency: Occasional (HP:0040283). (ORPHA:210272)
- Migraine (HP:0002076): Migraine is a chronic neurological disorder characterized by episodic attacks of headache and associated symptoms. Evidence: TAS. Frequency: Occasional (HP:0040283). (ORPHA:210272)
- Headache (HP:0002315): Cephalgia, or pain sensed in various parts of the head, not confined to the area of distribution of any nerve. Evidence: TAS. Frequency: Occasional (HP:0040283). (ORPHA:210272)
- Fatigue (HP:0012378): A subjective feeling of tiredness characterized by a lack of energy and motivation. Evidence: TAS. Frequency: Occasional (HP:0040283). (ORPHA:210272)
- Eyelid fasciculation (HP:0030826): Tiny, repetitive muscle contractions in the eyelids, causing the appearance of twitching. Evidence: TAS. Frequency: Occasional (HP:0040283). (ORPHA:210272)
Not associated with this disease:
- Abnormal vestibulo-ocular reflex (HP:0007670): An abnormality of the vestibulo-ocular reflex (VOR). The VOR attempts to keep the image stable on the retina. Ideally passive or active head movements in one direction are compensated for by eye movements of equal magnitude. Evidence: TAS. (ORPHA:210272)
- Brain imaging abnormality (HP:0410263): An anomaly of metabolism or structure of the brain identified by imaging. Evidence: TAS. (ORPHA:210272)